- High palate (HP:0000218): Height of the palate more than 2 SD above the mean (objective) or palatal height at the level of the first permanent molar more than twice the height of the teeth (subjective). Evidence: TAS. Frequency: Very frequent (HP:0040281). (ORPHA:3079)
- Microcephaly (HP:0000252): Head circumference below 2 standard deviations below the mean for age and gender. Evidence: TAS. Frequency: Very frequent (HP:0040281). (ORPHA:3079)
- Mandibular prognathia (HP:0000303): Abnormal prominence of the chin related to increased length of the mandible. Evidence: TAS. Frequency: Very frequent (HP:0040281). (ORPHA:3079)
- Hypertelorism (HP:0000316): Interpupillary distance more than 2 SD above the mean (alternatively, the appearance of an increased interpupillary distance or widely spaced eyes). Evidence: TAS. Frequency: Very frequent (HP:0040281). (ORPHA:3079)
- Sloping forehead (HP:0000340): Inclination of the anterior surface of the forehead from the vertical more than two standard deviations above the mean (objective); or apparently excessive posterior sloping of the forehead in a lateral view. Evidence: TAS. Frequency: Very frequent (HP:0040281). (ORPHA:3079)
- Macrotia (HP:0000400): Median longitudinal ear length greater than two standard deviations above the mean and median ear width greater than two standard deviations above the mean (objective); or, apparent increase in length and width of the pinna (subjective). Evidence: TAS. Frequency: Very frequent (HP:0040281). (ORPHA:3079)
- Wide nasal bridge (HP:0000431): Increased breadth of the nasal bridge (and with it, the nasal root). Evidence: TAS. Frequency: Very frequent (HP:0040281). (ORPHA:3079)
- Downslanted palpebral fissures (HP:0000494): The palpebral fissure inclination is more than two standard deviations below the mean. Evidence: TAS. Frequency: Very frequent (HP:0040281). (ORPHA:3079)
- Photophobia (HP:0000613): Excessive sensitivity to light with the sensation of discomfort or pain in the eyes due to exposure to bright light. Evidence: TAS. Frequency: Very frequent (HP:0040281). (ORPHA:3079)
- Dental malocclusion (HP:0000689): Dental malocclusion refers to an abnormality of the occlusion, or alignment, of the teeth and the way the upper and lower teeth fit together, resulting in overcrowding of teeth or in abnormal bite patterns. Evidence: TAS. Frequency: Very frequent (HP:0040281). (ORPHA:3079)
- Pectus carinatum (HP:0000768): A deformity of the chest caused by overgrowth of the ribs and characterized by protrusion of the sternum. Evidence: TAS. Frequency: Very frequent (HP:0040281). (ORPHA:3079)
- Abnormal fingernail morphology (HP:0001231): An abnormality of the fingernails. Evidence: TAS. Frequency: Very frequent (HP:0040281). (ORPHA:3079)
- Intellectual disability (HP:0001249): The term intellectual disability or intellectual developmental disorder is used to describe significantly sub-average intellectual and adaptive functioning based on clinical assessment and as measured by individually administered, appropriately normed, standardized and validated tests of intellectual functioning and adaptive behavior, with onset during the developmental period from infancy through adolescence. Evidence: TAS. Frequency: Very frequent (HP:0040281). (ORPHA:3079)
- Umbilical hernia (HP:0001537): Protrusion of abdominal contents through a defect in the abdominal wall musculature around the umbilicus. Skin and subcutaneous tissue overlie the defect. Evidence: TAS. Frequency: Very frequent (HP:0040281). (ORPHA:3079)
- Abnormal cardiac septum morphology (HP:0001671): An anomaly of the intra-atrial or intraventricular septum. Evidence: TAS. Frequency: Very frequent (HP:0040281). (ORPHA:3079)
- Spastic gait (HP:0002064): Spasticity is manifested by increased stretch reflex which is intensified with movement velocity. This results in excessive and inappropriate muscle activation which can contribute to muscle hypertonia. Spastic gait is characterized by manifestations such as muscle hypertonia, stiff knee, and circumduction of the leg. Evidence: TAS. Frequency: Very frequent (HP:0040281). (ORPHA:3079)
- Abnormal speech pattern (HP:0002167): An abnormality in the sound (volume) or cadence (rate) of speech. Evidence: TAS. Frequency: Very frequent (HP:0040281). (ORPHA:3079)
- Fine hair (HP:0002213): Hair that is fine or thin to the touch. Evidence: TAS. Frequency: Very frequent (HP:0040281). (ORPHA:3079)
- Abnormal pelvic girdle bone morphology (HP:0002644): An abnormality of the bony pelvic girdle, which is a ring of bones connecting the vertebral column to the femurs. Evidence: TAS. Frequency: Very frequent (HP:0040281). (ORPHA:3079)
- Abnormal calvaria morphology (HP:0002683): Abnormality of the morphology (structure) of the calvaria (skullcap), that is, of that part of the skull that is made up of the superior portions of the frontal bone, occipital bone, and parietal bones and covers the cranial cavity that contains the brain. Evidence: TAS. Frequency: Very frequent (HP:0040281). (ORPHA:3079)
- Clinodactyly of the 5th finger (HP:0004209): Clinodactyly refers to a bending or curvature of the fifth finger in the radial direction (i.e., towards the 4th finger). Evidence: TAS. Frequency: Very frequent (HP:0040281). (ORPHA:3079)
- Short stature (HP:0004322): A height below that which is expected according to age and gender norms. Although there is no universally accepted definition of short stature, many refer to "short stature" as height more than 2 standard deviations below the mean for age and gender (or below the 3rd percentile for age and gender dependent norms). Evidence: TAS. Frequency: Very frequent (HP:0040281). (ORPHA:3079)
- Reduced bone mineral density (HP:0004349): A reduction of bone mineral density, that is, of the amount of matter per cubic centimeter of bones. Evidence: TAS. Frequency: Very frequent (HP:0040281). (ORPHA:3079)
- Biparietal narrowing (HP:0004422): A narrowing of the biparietal diameter (i.e., of the transverse distance between the protuberances of the two parietal bones of the skull). Evidence: TAS. Frequency: Very frequent (HP:0040281). (ORPHA:3079)
- Abnormal dental morphology (HP:0006482): An abnormality of the morphology of the tooth. Evidence: TAS. Frequency: Very frequent (HP:0040281). (ORPHA:3079)
- Hyperconvex thumb nails (HP:0008407). Evidence: TAS. Frequency: Very frequent (HP:0040281). (ORPHA:3079)
- Cuboid-shaped thoracolumbar vertebral bodies (HP:0008425). Evidence: TAS. Frequency: Very frequent (HP:0040281). (ORPHA:3079)
- Open bite (HP:0010807): Visible space between the dental arches in occlusion. Evidence: TAS. Frequency: Very frequent (HP:0040281). (ORPHA:3079)
- Hydronephrosis (HP:0000126): Severe distention of the kidney with dilation of the renal pelvis and calices. Evidence: TAS. Frequency: Frequent (HP:0040282). (ORPHA:3079)
- Blepharophimosis (HP:0000581): A fixed reduction in the vertical distance between the upper and lower eyelids with short palpebral fissures. Evidence: TAS. Frequency: Frequent (HP:0040282). (ORPHA:3079)
These phenotypes are associated with the disease Intellectual disability, Buenos-Aires type (ORPHA:3079).